Phenotypes associated with the disease epilepsy, idiopathic generalized, susceptibility to, 9 (OMIM:607682):
- Bilateral tonic-clonic seizure (HP:0002069): A bilateral tonic-clonic seizure is a seizure defined by a tonic (bilateral increased tone, lasting seconds to minutes) and then a clonic (bilateral sustained rhythmic jerking) phase. Evidence: PCS. Frequency: 2/11. (PMID:10762541)
- Juvenile onset (HP:0003621): Onset of signs or symptoms of disease between the age of 5 and 15 years. Evidence: PCS. Frequency: 2/6. (PMID:10762541)
- Truncal ataxia (HP:0002078): Truncal ataxia is a sign of ataxia characterized by instability of the trunk. It usually occurs during sitting. Evidence: PCS. Frequency: 1/11. (PMID:10762541)
- Febrile seizure (within the age range of 3 months to 6 years) (HP:0002373): A febrile seizure is any type of seizure (most often a generalized tonic-clonic seizure) occurring with fever (at least 38 degrees Celsius) but in the absence of central nervous system infection, severe metabolic disturbance or other alternative precipitant in children between the ages of 3 months and 6 years. Evidence: PCS. Frequency: 2/11. (PMID:10762541)
- Episodic ataxia (HP:0002131): Periodic spells of incoordination and imbalance, that is, episodes of ataxia typically lasting from 10 minutes to several hours or days. Evidence: PCS. Frequency: 2/11. (PMID:10762541)
- Generalized non-motor (absence) seizure (HP:0002121): A generalized non-motor (absence) seizure is a type of a type of dialeptic seizure that is of electrographically generalized onset. It is a generalized seizure characterized by an interruption of activities, a blank stare, and usually the person will be unresponsive when spoken to. Any ictal motor phenomena are minor in comparison to these non-motor features. Evidence: PCS. Frequency: 1/11. (PMID:10762541)
- Dysarthria (HP:0001260): Dysarthric speech is a general description referring to a neurological speech disorder characterized by poor articulation. Depending on the involved neurological structures, dysarthria may be further classified as spastic, flaccid, ataxic, hyperkinetic and hypokinetic, or mixed. Evidence: PCS. Frequency: 3/11. (PMID:10762541)
- Generalized tonic seizure (HP:0010818): A generalized tonic seizure is a type of generalized motor seizure characterized by bilateral limb stiffening or elevation, often with neck stiffening without a subsequent clonic phase. The tonic activity can be a sustained abnormal posture, either in extension or flexion, sometimes accompanied by tremor of the extremities. Evidence: PCS. Frequency: 1/11. (PMID:10762541)
- Postural instability (HP:0002172): A tendency to fall or the inability to keep oneself from falling; imbalance. The retropulsion test is widely regarded as the gold standard to evaluate postural instability, Use of the retropulsion test includes a rapid balance perturbation in the backward direction, and the number of balance correcting steps (or total absence thereof) is used to rate the degree of postural instability. Healthy subjects correct such perturbations with either one or two large steps, or without taking any steps, hinging rapidly at the hips while swinging the arms forward as a counterweight. In patients with balance impairment, balance correcting steps are often too small, forcing patients to take more than two steps. Taking three or more steps is generally considered to be abnormal, and taking more than five steps is regarded as being clearly abnormal. Markedly affected patients continue to step backward without ever regaining their balance and must be caught by the examiner (this would be called true retropulsion). Even more severely affected patients fail to correct entirely, and fall backward like a pushed toy soldier, without taking any corrective steps. Evidence: PCS. Frequency: 3/11. (PMID:10762541)
- Paroxysmal vertigo (HP:0010532): Paroxysmal episodes of vertigo. Evidence: PCS. Frequency: 2/11. (PMID:10762541)
- EEG with polyspike wave complexes (HP:0002392): The presence of complexes of repetitive spikes and waves in EEG. Evidence: PCS. (PMID:10762541)
- Typical absence seizure (HP:0011147): A typical absence seizure is a type of generalized non-motor (absence) seizure characterized by its sudden onset, interruption of ongoing activities, a blank stare, possibly a brief upward deviation of the eyes. Usually the patient will be unresponsive when spoken to. Duration is a few seconds to half a minute with very rapid recovery. Although not always available, an EEG would usually show 3 Hz generalized epileptiform discharges during the event. Evidence: PCS. Frequency: 1/11. (PMID:10762541)
- EEG with spike-wave complexes (HP:0010850): Complexes of spikes (<70 ms) and sharp waves (70-200 ms), which are sharp transient waves that have a strong association with epilepsy, in cerebral electrical activity recorded along the scalp by electroencephalography (EEG). Evidence: PCS. Frequency: 1/11. (PMID:10762541)
- Intermediate young adult onset (HP:0025709): Onset of disease at an age of greater than or equal to 19 to under 25 years. Evidence: PCS. Frequency: 1/6. (PMID:10762541)
- Bilateral tonic-clonic seizure on awakening (HP:0007193): Bilateral tonic-clonic seizure of either generalized or focal onset occurring on or soon after wakening (typically within 90 minutes of waking, regardless of the time of day). Evidence: TAS. (OMIM:607682)
- Atypical absence seizure (HP:0007270): An atypical absence seizure is a type of generalized non-motor (absence) seizure characterized by interruption of ongoing activities and reduced responsiveness. In comparison to a typical absence seizure, changes in tone may be more pronounced, onset and/or cessation may be less abrupt, and the duration of the ictus and post-ictal recovery may be longer. Although not always available, an EEG often demonstrates slow (<3 Hz), irregular, generalized spike-wave activity. Evidence: PCS. Frequency: 1/11. (PMID:10762541)
- Nystagmus (HP:0000639): Rhythmic, involuntary oscillations of one or both eyes related to abnormality in fixation, conjugate gaze, or vestibular mechanisms. Evidence: PCS. Frequency: 1/11. (PMID:10762541)
- Childhood onset (HP:0011463): Onset of disease at the age of between 1 and 5 years. Evidence: PCS. Frequency: 2/6. (PMID:10762541)
- Morning myoclonic jerks (HP:0007000). Evidence: PCS. Frequency: 1/11. (PMID:10762541)
- Late young adult onset (HP:0025710): Onset of disease at an age of greater than or equal to 25 to under 40 years. Evidence: PCS. Frequency: 1/6. (PMID:10762541)
- Intellectual disability (HP:0001249): The term intellectual disability or intellectual developmental disorder is used to describe significantly sub-average intellectual and adaptive functioning based on clinical assessment and as measured by individually administered, appropriately normed, standardized and validated tests of intellectual functioning and adaptive behavior, with onset during the developmental period from infancy through adolescence. Evidence: PCS. Frequency: 0/11. (PMID:10762541)
- Autosomal dominant inheritance (HP:0000006): A mode of inheritance that is observed for traits related to a gene encoded on one of the autosomes (i.e., the human chromosomes 1-22) in which a trait manifests in heterozygotes. In the context of medical genetics, an autosomal dominant disorder is caused when a single copy of the mutant allele is present. Males and females are affected equally, and can both transmit the disorder with a risk of 50% for each child of inheriting the mutant allele. Evidence: PCS. (PMID:10762541)
- Myoclonus (HP:0001336): Very brief, involuntary random muscular contractions occurring at rest, in response to sensory stimuli, or accompanying voluntary movements. Evidence: PCS. Frequency: 1/11. (PMID:10762541)